- Unilateral cryptorchidism (HP:0012741): Absence of a testis from the scrotum on one side owing to failure of the testis or testes to descend through the inguinal canal to the scrotum. Evidence: IEA. (OMIM:219050)
- Cryptorchidism (HP:0000028): Testis in inguinal canal. That is, absence of one or both testes from the scrotum owing to failure of the testis or testes to descend through the inguinal canal to the scrotum. Evidence: IEA. (OMIM:219050)
- Autosomal dominant inheritance (HP:0000006): A mode of inheritance that is observed for traits related to a gene encoded on one of the autosomes (i.e., the human chromosomes 1-22) in which a trait manifests in heterozygotes. In the context of medical genetics, an autosomal dominant disorder is caused when a single copy of the mutant allele is present. Males and females are affected equally, and can both transmit the disorder with a risk of 50% for each child of inheriting the mutant allele. Evidence: TAS. (OMIM:219050)
- Renal agenesis (HP:0000104): Agenesis, that is, failure of the kidney to develop during embryogenesis and development. Evidence: IEA. (OMIM:219050)
These phenotypes are associated with the disease cryptorchidism (OMIM:219050).